- Seizure (HP:0001250): A seizure is an intermittent abnormality of nervous system physiology characterized by a transient occurrence of signs and/or symptoms due to abnormal excessive or synchronous neuronal activity in the brain. Evidence: IEA. (OMIM:217200)
- Autosomal recessive inheritance (HP:0000007): A mode of inheritance that is observed for traits related to a gene encoded on one of the autosomes (i.e., the human chromosomes 1-22) in which a trait manifests in individuals with two pathogenic alleles, either homozygotes (two copies of the same mutant allele) or compound heterozygotes (whereby each copy of a gene has a distinct mutant allele). Evidence: IEA. (OMIM:217200)
- Death in infancy (HP:0001522): Death within the first 24 months of life. Evidence: IEA. (OMIM:217200)
- Intellectual disability (HP:0001249): The term intellectual disability or intellectual developmental disorder is used to describe significantly sub-average intellectual and adaptive functioning based on clinical assessment and as measured by individually administered, appropriately normed, standardized and validated tests of intellectual functioning and adaptive behavior, with onset during the developmental period from infancy through adolescence. Evidence: IEA. (OMIM:217200)
- Myoclonus (HP:0001336): Very brief, involuntary random muscular contractions occurring at rest, in response to sensory stimuli, or accompanying voluntary movements. Evidence: IEA. (OMIM:217200)
These phenotypes are associated with the disease convulsive disorder, familial, with prenatal or early onset (OMIM:217200).